- Abnormality of the dentition (HP:0000164): Any abnormality of the teeth. Evidence: TAS. Frequency: Very frequent (HP:0040281). (ORPHA:2222)
- Gingival overgrowth (HP:0000212): Hyperplasia of the gingiva (that is, a thickening of the soft tissue overlying the alveolar ridge. The degree of thickening ranges from involvement of the interdental papillae alone to gingival overgrowth covering the entire tooth crown. Evidence: TAS. Frequency: Occasional (HP:0040283). (ORPHA:2222)
- Hearing impairment (HP:0000365): A decreased magnitude of the sensory perception of sound. Evidence: TAS. Frequency: Very frequent (HP:0040281). (ORPHA:2222)
- Thick eyebrow (HP:0000574): Increased density/number and/or increased diameter of eyebrow hairs. Evidence: TAS. Frequency: Very frequent (HP:0040281). (ORPHA:2222)
- Delayed eruption of teeth (HP:0000684): Delayed tooth eruption, which can be defined as tooth eruption more than 2 SD beyond the mean eruption age. Evidence: TAS. Frequency: Very frequent (HP:0040281). (ORPHA:2222)
- Abnormal skin pigmentation (HP:0001000): An abnormality of the pigmentation of the skin. Evidence: TAS. Frequency: Frequent (HP:0040282). (ORPHA:2222)
- Generalized hirsutism (HP:0002230): Abnormally increased hair growth over much of the entire body. Evidence: TAS. Frequency: Very frequent (HP:0040281). (ORPHA:2222)
These phenotypes are associated with the disease Hypertrichosis lanuginosa congenita (ORPHA:2222).